- Seizure (HP:0001250): A seizure is an intermittent abnormality of nervous system physiology characterized by a transient occurrence of signs and/or symptoms due to abnormal excessive or synchronous neuronal activity in the brain. Evidence: PCS. Onset: Infantile onset (HP:0003593). (PMID:26566883)
- Global developmental delay (HP:0001263): A delay in the achievement of motor or mental milestones in the domains of development of a child, including motor skills, speech and language, cognitive skills, and social and emotional skills. This term should only be used to describe children younger than five years of age. Evidence: PCS. (PMID:26566883)
- Aggressive behavior (HP:0000718): Behavior or an act aimed at harming a person, animal, or physical property (e.g., acts of physical violence; shouting, swearing, and using harsh language; slashing someone's tires). Evidence: PCS. Frequency: 1/7. (PMID:26566883)
- Infantile onset (HP:0003593): Onset of signs or symptoms of disease between 28 days to one year of life. Evidence: PCS. Frequency: 14/14. (PMID:26566883)
- Autosomal recessive inheritance (HP:0000007): A mode of inheritance that is observed for traits related to a gene encoded on one of the autosomes (i.e., the human chromosomes 1-22) in which a trait manifests in individuals with two pathogenic alleles, either homozygotes (two copies of the same mutant allele) or compound heterozygotes (whereby each copy of a gene has a distinct mutant allele). Evidence: PCS. (PMID:26566883)
- Severe intellectual disability (HP:0010864): Severe intellectual disability (ID) is defined as a type of ID characterized by severely sub-average adaptive functioning and intellectual functioning, with an intelligence quotient (IQ) the range of 20-34. Evidence: PCS. Frequency: 7/7. (PMID:26566883)
These phenotypes are associated with the disease intellectual disability, autosomal recessive 52 (OMIM:616887).